Phenotypes associated with the disease spermatogenic failure 26 (OMIM:617961):
- Male infertility (HP:0003251). Evidence: PCS. Frequency: 1/1. (PMID:28905369)
- Young adult onset (HP:0011462): Onset of disease at the age of between 16 and 40 years. Evidence: PCS. Frequency: 1/1. (PMID:28905369)
- Autosomal recessive inheritance (HP:0000007): A mode of inheritance that is observed for traits related to a gene encoded on one of the autosomes (i.e., the human chromosomes 1-22) in which a trait manifests in individuals with two pathogenic alleles, either homozygotes (two copies of the same mutant allele) or compound heterozygotes (whereby each copy of a gene has a distinct mutant allele). Evidence: PCS. (PMID:28905369)
- Acephalic spermatozoa (HP:0012869): Spermatozoa with very small cranial ends devoid of any nuclear material, that is, lacking a typical sperm head. Evidence: PCS. Frequency: 1/1. (PMID:28905369)